- Elevated circulating creatine kinase activity (HP:0003236): The activity of creatine kinase in the blood circulation is above the upper limit of normal. Evidence: PCS. Frequency: 5/5. (PMID:16575835)
- Facial palsy (HP:0010628): Facial nerve palsy is a dysfunction of cranial nerve VII (the facial nerve) that results in inability to control facial muscles on the affected side with weakness of the muscles of facial expression and eye closure. This can either be present in unilateral or bilateral form. Evidence: TAS. (OMIM:613155)
- Inability to walk (HP:0002540): Incapability to ambulate. Evidence: PCS. Frequency: 5/5. (PMID:16575835)
- Hypoplasia of the brainstem (HP:0002365): Underdevelopment of the brainstem. Evidence: PCS. Frequency: 2/2. (PMID:16575835)
- Flexion contracture (HP:0001371): A flexion contracture is a bent (flexed) joint that cannot be straightened actively or passively. It is thus a chronic loss of joint motion due to structural changes in muscle, tendons, ligaments, or skin that prevents normal movement of joints. Evidence: TAS. (OMIM:613155)
- Infantile onset (HP:0003593): Onset of signs or symptoms of disease between 28 days to one year of life. Evidence: TAS. (OMIM:613155)
- Enlarged cisterna magna (HP:0002280): Increase in size of the cisterna magna, one of three principal openings in the subarachnoid space between the arachnoid and pia mater, located between the cerebellum and the dorsal surface of the medulla oblongata. Evidence: TAS. (OMIM:613155)
- Severe intellectual disability (HP:0010864): Severe intellectual disability (ID) is defined as a type of ID characterized by severely sub-average adaptive functioning and intellectual functioning, with an intelligence quotient (IQ) the range of 20-34. Evidence: PCS. Frequency: 5/5. (PMID:16575835)
- Developmental cataract (HP:0000519): A cataract that occurs congenitally as the result of a developmental defect, in contrast to the majority of cataracts that occur in adulthood as the result of degenerative changes of the lens. Evidence: TAS. Frequency: Occasional (HP:0040283). (OMIM:613155)
- Hydrocephalus (HP:0000238): Hydrocephalus is an active distension of the ventricular system of the brain resulting from inadequate passage of CSF from its point of production within the cerebral ventricles to its point of absorption into the systemic circulation. Evidence: PCS. Frequency: 3/5. (PMID:16575835)
- Macroglossia (HP:0000158): Increased length and width of the tongue. Evidence: PCS. Frequency: 2/3. (PMID:16575835)
- Retinal dystrophy (HP:0000556): Retinal dystrophy is an abnormality of the retina associated with a hereditary process. Retinal dystrophies are defined by their predominantly monogenic inheritance and they are frequently associated with loss or dysfunction of photoreceptor cells as a primary or secondary event. Evidence: PCS. Frequency: 0/5. (PMID:16575835)
- Cerebellar vermis hypoplasia (HP:0001320): Underdevelopment of the vermis of cerebellum. Evidence: PCS. Frequency: 5/5. (PMID:16575835)
- Microcephaly (HP:0000252): Head circumference below 2 standard deviations below the mean for age and gender. Evidence: PCS. Frequency: 5/5. (PMID:16575835)
- Absent speech (HP:0001344): Complete lack of development of speech and language abilities. Evidence: PCS. Frequency: 2/5. (PMID:16575835)
- Cerebellar hypoplasia (HP:0001321): Cerebellar hypoplasia is a descriptive term implying a cerebellum with a reduced volume, but a normal shape and is stable over time. Evidence: PCS. Frequency: 5/5. (PMID:16575835)
- Hypoplasia of the corpus callosum (HP:0002079): Underdevelopment of the corpus callosum. Evidence: PCS. Frequency: 1/5. (PMID:16575835)
- Global developmental delay (HP:0001263): A delay in the achievement of motor or mental milestones in the domains of development of a child, including motor skills, speech and language, cognitive skills, and social and emotional skills. This term should only be used to describe children younger than five years of age. Evidence: TAS. (OMIM:613155)
- Muscular dystrophy (HP:0003560): The term dystrophy means abnormal growth. However, muscular dystrophy is used to describe primary myopathies with a genetic basis and a progressive course characterized by progressive skeletal muscle weakness and wasting, defects in muscle proteins, and histological features of muscle fiber degeneration (necrosis) and regeneration. If possible, it is preferred to use other HPO terms to describe the precise phenotypic abnormalities. Evidence: TAS. Frequency: 20/20. (OMIM:613155)
- Focal cortical dysplasia (HP:0032046): A type of malformation of cortical development that primarily affects areas of neocortex. It can be identified on conventional magnetic resonance imaging as focal cortical thickening, abnormal gyration, and blurring between gray and white matter, often associated with clusters of heterotopic neurons. Evidence: PCS. Frequency: 1/2. (PMID:16575835)
- Abnormal left ventricular function (HP:0005162): Inability of the left ventricle to perform its normal physiologic function. Failure is either due to an inability to contract the left ventricle or the inability to relax completely and fill with blood during diastole. Evidence: IEA. (OMIM:613155)
- Cerebellar dysplasia (HP:0007033): Cerebellar dysplasia (abnormal growth or development) is defined by abnormal cerebellar foliation, white matter arborization, and gray-white matter junction. Cerebellar dysplasia is a neuroimaging finding that describes abnormalities of both the cerebellar cortex and white matter and is associated with variable neurodevelopmental outcome. Dysplasia may globally involve the cerebellum or affect only one cerebellar hemisphere. In addition, cerebellar dysplasia may be associated with cortical/subcortical cysts. Evidence: TAS. (OMIM:613155)
- Calf muscle hypertrophy (HP:0008981): Muscle hypertrophy affecting the calf muscles. Evidence: PCS. Frequency: 4/5. (PMID:16575835)
- Autosomal recessive inheritance (HP:0000007): A mode of inheritance that is observed for traits related to a gene encoded on one of the autosomes (i.e., the human chromosomes 1-22) in which a trait manifests in individuals with two pathogenic alleles, either homozygotes (two copies of the same mutant allele) or compound heterozygotes (whereby each copy of a gene has a distinct mutant allele). Evidence: PCS. (PMID:16575835)
- Microphthalmia (HP:0000568): A developmental anomaly characterized by abnormal smallness of one or both eyes. Evidence: PCS. Frequency: 0/5. (PMID:16575835)
- Cardiomyopathy (HP:0001638): A myocardial disorder in which the heart muscle is structurally and functionally abnormal, in the absence of coronary artery disease, hypertension, valvular disease and congenital heart disease sufficient to cause the observed myocardial abnormality. Evidence: TAS. Frequency: Occasional (HP:0040283). (OMIM:613155)
- Myopia (HP:0000545): An abnormality of refraction characterized by the ability to see objects nearby clearly, while objects in the distance appear blurry. Evidence: PCS. Frequency: 3/5. (PMID:16575835)
These phenotypes are associated with the disease muscular dystrophy-dystroglycanopathy (congenital with intellectual disability), type B1 (OMIM:613155).